Phenotypes associated with the disease Iridocorneal endothelial syndrome (ORPHA:64734):
- Glaucoma (HP:0000501): Glaucoma refers loss of retinal ganglion cells in a characteristic pattern of optic neuropathy usually associated with increased intraocular pressure. Evidence: TAS. Frequency: Frequent (HP:0040282). (ORPHA:64734)
- Progressive visual loss (HP:0000529): A reduction of previously attained ability to see. Evidence: TAS. Frequency: Frequent (HP:0040282). (ORPHA:64734)
- Iris atrophy (HP:0001089): Loss of iris tissue (atrophy). Evidence: TAS. Frequency: Frequent (HP:0040282). (ORPHA:64734)
- Reduced visual acuity (HP:0007663). Evidence: TAS. Frequency: Frequent (HP:0040282). (ORPHA:64734)
- Ectopia pupillae (HP:0009918): A malposition of the pupil owing to a developmental defect of the iris. Evidence: TAS. Frequency: Frequent (HP:0040282). (ORPHA:64734)
- Anterior synechiae of the anterior chamber (HP:0011483): Adhesions between the iris and the cornea. Evidence: TAS. Frequency: Frequent (HP:0040282). (ORPHA:64734)
- Abnormal migration of corneal endothelium (HP:0011489): Abnormal migration of corneal endothelium. Evidence: TAS. Frequency: Frequent (HP:0040282). (ORPHA:64734)
- Corneal stromal edema (HP:0012040): Abnormal accumulation of fluid and swelling of the stroma of cornea. Evidence: TAS. Frequency: Frequent (HP:0040282). (ORPHA:64734)
- Central heterochromia (HP:0007818): The presence of distinct colors in the central (pupillary) zone of the iris than in the mid-peripheral (ciliary) zone. Evidence: TAS. Frequency: Occasional (HP:0040283). (ORPHA:64734)
- Hypoplastic iris stroma (HP:0007990): Underdevelopment of the stroma of iris. Evidence: TAS. Frequency: Occasional (HP:0040283). (ORPHA:64734)
- Posterior synechiae of the anterior chamber (HP:0011484): Adhesions between the iris and the lens. Evidence: TAS. Frequency: Occasional (HP:0040283). (ORPHA:64734)
- Polycoria (HP:0011500): Multiple pupils. Evidence: TAS. Frequency: Occasional (HP:0040283). (ORPHA:64734)
- Iris nevus (HP:0011525): A benign brown pigmented area over the iris representing proliferation of melanocyte cells in the stromal layer of the iris. An iris nevus can be flat or occasionally slightly elevated. Evidence: TAS. Frequency: Occasional (HP:0040283). (ORPHA:64734)
- Abnormal pupil shape (HP:0025309): A deviation from the normal circular shape of the pupil. Evidence: TAS. Frequency: Occasional (HP:0040283). (ORPHA:64734)
- Uveal ectropion (HP:0025358): Presence of iris pigment epithelium on the anterior surface of the iris. Evidence: TAS. Frequency: Occasional (HP:0040283). (ORPHA:64734)
- Heterochromia iridis (HP:0001100): Heterochromia iridis is a difference in the color of the iris in the two eyes. Evidence: TAS. Frequency: Very rare (HP:0040284). (ORPHA:64734)